Phenotypes associated with the disease ear pits, posterior helical (OMIM:128710):
- Posterior helix pit (HP:0008523): Permanent indentation on the posteromedial aspect of the helix that may be sharply or indistinctly delineated. Evidence: TAS. (OMIM:128710)
- Autosomal dominant inheritance (HP:0000006): A mode of inheritance that is observed for traits related to a gene encoded on one of the autosomes (i.e., the human chromosomes 1-22) in which a trait manifests in heterozygotes. In the context of medical genetics, an autosomal dominant disorder is caused when a single copy of the mutant allele is present. Males and females are affected equally, and can both transmit the disorder with a risk of 50% for each child of inheriting the mutant allele. Evidence: TAS. (OMIM:128710)